Phenotypes associated with the disease head and neck squamous cell carcinoma (OMIM:275355):
- Squamous cell carcinoma (HP:0002860): The presence of squamous cell carcinoma of the skin. Evidence: TAS. (OMIM:275355)
- Autosomal recessive inheritance (HP:0000007): A mode of inheritance that is observed for traits related to a gene encoded on one of the autosomes (i.e., the human chromosomes 1-22) in which a trait manifests in individuals with two pathogenic alleles, either homozygotes (two copies of the same mutant allele) or compound heterozygotes (whereby each copy of a gene has a distinct mutant allele). Evidence: TAS. (OMIM:275355)